Phenotypes associated with the disease hearing loss, autosomal dominant 90 (OMIM:620722):
- Juvenile onset (HP:0003621): Onset of signs or symptoms of disease between the age of 5 and 15 years. Evidence: PCS. (PMID:29880844)
- Bilateral sensorineural hearing impairment (HP:0008619): A form of sensorineural hearing impairment that affects both ears. Evidence: PCS. (PMID:29880844)
- Adult onset (HP:0003581): Onset of disease manifestations in adulthood, defined here as at the age of 16 years or later. Evidence: PCS. (PMID:29880844)
- Tinnitus (HP:0000360): Tinnitus is an auditory perception that can be described as the experience of sound, in the ear or in the head, in the absence of external acoustic stimulation. Evidence: PCS. Frequency: 24/36. (PMID:29880844)
- Autosomal dominant inheritance (HP:0000006): A mode of inheritance that is observed for traits related to a gene encoded on one of the autosomes (i.e., the human chromosomes 1-22) in which a trait manifests in heterozygotes. In the context of medical genetics, an autosomal dominant disorder is caused when a single copy of the mutant allele is present. Males and females are affected equally, and can both transmit the disorder with a risk of 50% for each child of inheriting the mutant allele. Evidence: PCS. (PMID:29880844)